- Polyhydramnios (HP:0001561): The presence of excess amniotic fluid in the uterus during pregnancy. Evidence: TAS. Frequency: Frequent (HP:0040282). (ORPHA:2300)
- Duodenal stenosis (HP:0100867): The narrowing or partial blockage of a portion of the duodenum. Evidence: TAS. Frequency: Very frequent (HP:0040281). (ORPHA:2300)
- Gastrointestinal atresia (HP:0002589). Evidence: TAS. Frequency: Very frequent (HP:0040281). (ORPHA:2300)
These phenotypes are associated with the disease Isolated multiple intestinal atresia (ORPHA:2300).